- Keratitis (HP:0000491): Inflammation of the cornea. Evidence: TAS. Frequency: Very frequent (HP:0040281). (ORPHA:163934)
- Dry skin (HP:0000958): Skin characterized by the lack of natural or normal moisture. Evidence: TAS. Frequency: Very frequent (HP:0040281). (ORPHA:163934)
- Keratoconjunctivitis sicca (HP:0001097): Dryness of the eye related to deficiency of the tear film components (aqueous, mucin, or lipid), lid surface abnormalities, or epithelial abnormalities. Keratoconjunctivitis sicca often results in a scratchy or sandy sensation (foreign body sensation) in the eyes, and may also be associated with itching, inability to produce tears, photosensitivity, redness, pain, and difficulty in moving the eyelids. Evidence: TAS. Frequency: Very frequent (HP:0040281). (ORPHA:163934)
- Corneal opacity (HP:0007957): A reduction of corneal clarity. Evidence: TAS. Frequency: Very frequent (HP:0040281). (ORPHA:163934)
- Abnormal eyelid morphology (HP:0000492): An abnormality of the eyelids. Evidence: TAS. Frequency: Frequent (HP:0040282). (ORPHA:163934)
- Blepharitis (HP:0000498): Inflammation of the eyelids. Evidence: TAS. Frequency: Frequent (HP:0040282). (ORPHA:163934)
- Photophobia (HP:0000613): Excessive sensitivity to light with the sensation of discomfort or pain in the eyes due to exposure to bright light. Evidence: TAS. Frequency: Frequent (HP:0040282). (ORPHA:163934)
- Blurred vision (HP:0000622): Lack of sharpness of vision resulting in the inability to see fine detail. Evidence: TAS. Frequency: Frequent (HP:0040282). (ORPHA:163934)
- Allergic conjunctivitis (HP:0007879): Allergic Conjunctivitis is an allergic inflammation of the conjunctiva. Evidence: TAS. Frequency: Frequent (HP:0040282). (ORPHA:163934)
- Loss of eyelashes (HP:0011457): This term refers to the loss of eyelashes that were previously present. Evidence: TAS. Frequency: Frequent (HP:0040282). (ORPHA:163934)
- Corneal neovascularization (HP:0011496): Ingrowth of new blood vessels into the cornea. Evidence: TAS. Frequency: Frequent (HP:0040282). (ORPHA:163934)
- Conjunctival hyperemia (HP:0030953): Dilatation of the blood vessels of the conjunctiva leading to a red appearance of the sclera. Evidence: TAS. Frequency: Frequent (HP:0040282). (ORPHA:163934)
- Ocular pain (HP:0200026): An unpleasant sensation characterized by physical discomfort (such as pricking, throbbing, or aching) localized to the eye. Evidence: TAS. Frequency: Frequent (HP:0040282). (ORPHA:163934)
- Corneal scarring (HP:0000559). Evidence: TAS. Frequency: Occasional (HP:0040283). (ORPHA:163934)
- Chemosis (HP:0012375): Edema (swelling) of the bulbar conjunctiva. Evidence: TAS. Frequency: Occasional (HP:0040283). (ORPHA:163934)
These phenotypes are associated with the disease Atopic keratoconjunctivitis (ORPHA:163934).